- Chronic rhinitis (HP:0002257): Chronic inflammation of the nasal mucosa. Evidence: PCS. Frequency: 1/1. (PMID:25927852)
- Rhinorrhea (HP:0031417): Increased discharge of mucus from the nose. Evidence: PCS. Frequency: 1/1. (PMID:25927852)
- Hearing impairment (HP:0000365): A decreased magnitude of the sensory perception of sound. Evidence: PCS. Frequency: 1/1. (PMID:25927852)
- Situs inversus totalis (HP:0001696): A left-right reversal (or mirror reflection) of the anatomical location of the major thoracic and abdominal organs. Evidence: PCS. Frequency: 1/1. (PMID:25927852)
- Dextrocardia (HP:0001651): The heart is located in the right hand sided hemithorax. That is, there is a left-right reversal (or "mirror reflection") of the anatomical location of the heart in which the heart is locate on the right side instead of the left. Evidence: PCS. Frequency: 1/1. (PMID:25927852)
- Bronchiectasis (HP:0002110): Persistent abnormal dilatation of the bronchi owing to localized and irreversible destruction and widening of the large airways. Evidence: PCS. Frequency: 1/1. (PMID:25927852)
- Wheezing (HP:0030828): A high-pitched whistling sound associated with labored breathing. Evidence: PCS. Frequency: 1/1. (PMID:25927852)
- Childhood onset (HP:0011463): Onset of disease at the age of between 1 and 5 years. Evidence: PCS. Frequency: 1/1. (PMID:25927852)
- Right aortic arch (HP:0012020): Aorta descends on right instead of on the left. Evidence: PCS. Frequency: 1/1. (PMID:25927852)
- Female infertility (HP:0008222). Evidence: PCS. Frequency: 1/1. (PMID:25927852)
- Autosomal recessive inheritance (HP:0000007): A mode of inheritance that is observed for traits related to a gene encoded on one of the autosomes (i.e., the human chromosomes 1-22) in which a trait manifests in individuals with two pathogenic alleles, either homozygotes (two copies of the same mutant allele) or compound heterozygotes (whereby each copy of a gene has a distinct mutant allele). Evidence: PCS. (PMID:25927852)
- Hypothyroidism (HP:0000821): Deficiency of thyroid hormone. Evidence: PCS. Frequency: 1/1. (PMID:25927852)
- Goiter (HP:0000853): An enlargement of the thyroid gland. Evidence: PCS. Frequency: 1/1. (PMID:25927852)
These phenotypes are associated with the disease ciliary dyskinesia, primary, 37 (OMIM:617577).